Phenotypes associated with the disease intellectual disability, X-linked 103 (OMIM:300982):
- Wide mouth (HP:0000154): Distance between the oral commissures more than 2 SD above the mean. Alternatively, an apparently increased width of the oral aperture (subjective). Evidence: PCS. Frequency: 1/1. (PMID:24817631)
- Lateral ventricle dilatation (HP:0006956). Evidence: PCS. Frequency: 1/1. (PMID:24817631)
- Micropenis (HP:0000054): Abnormally small penis. At birth, the normal penis is about 3 cm (stretched length from pubic tubercle to tip of penis) with micropenis less than 2.0-2.5 cm. Evidence: PCS. Frequency: 1/1. (PMID:24817631)
- Absent speech (HP:0001344): Complete lack of development of speech and language abilities. Evidence: PCS. Frequency: 1/1. (PMID:24817631)
- Delayed speech and language development (HP:0000750): A degree of language development that is significantly below the norm for a child of a specified age. Evidence: PCS. Frequency: 1/1. (PMID:24817631)
- Short palm (HP:0004279): Short palm. Evidence: PCS. Frequency: 1/1. (PMID:24817631)
- Anteverted nares (HP:0000463): Anteriorly-facing nostrils viewed with the head in the Frankfurt horizontal and the eyes of the observer level with the eyes of the subject. This gives the appearance of an upturned nose (upturned nasal tip). Evidence: PCS. Frequency: 1/1. (PMID:24817631)
- Delayed ability to walk (HP:0031936): A failure to achieve the ability to walk at an appropriate developmental stage. Most children learn to walk in a series of stages, and learn to walk short distances independently between 12 and 15 months. Evidence: PCS. Frequency: 1/1. (PMID:24817631)
- Seizure (HP:0001250): A seizure is an intermittent abnormality of nervous system physiology characterized by a transient occurrence of signs and/or symptoms due to abnormal excessive or synchronous neuronal activity in the brain. Evidence: PCS. Frequency: 1/1. (PMID:24817631)
- Global developmental delay (HP:0001263): A delay in the achievement of motor or mental milestones in the domains of development of a child, including motor skills, speech and language, cognitive skills, and social and emotional skills. This term should only be used to describe children younger than five years of age. Evidence: PCS. Frequency: 1/1. (PMID:24817631)
- Coarse facial features (HP:0000280): Absence of fine and sharp appearance of brows, nose, lips, mouth, and chin, usually because of rounded and heavy features or thickened skin with or without thickening of subcutaneous and bony tissues. Evidence: PCS. Frequency: 1/1. (PMID:24817631)
- X-linked recessive inheritance (HP:0001419): A mode of inheritance that is observed for recessive traits related to a gene encoded on the X chromosome. In the context of medical genetics, X-linked recessive disorders manifest in males (who have one copy of the X chromosome and are thus hemizygotes), but generally not in female heterozygotes who have one mutant and one normal allele. Evidence: PCS. (PMID:25644381)
- Bilateral cryptorchidism (HP:0008689): Absence of both testes from the scrotum owing to failure of the testis or testes to descend through the inguinal canal to the scrotum. Evidence: PCS. Frequency: 1/1. (PMID:24817631)
- Intellectual disability (HP:0001249): The term intellectual disability or intellectual developmental disorder is used to describe significantly sub-average intellectual and adaptive functioning based on clinical assessment and as measured by individually administered, appropriately normed, standardized and validated tests of intellectual functioning and adaptive behavior, with onset during the developmental period from infancy through adolescence. Evidence: PCS. Frequency: 8/8. (PMID:25644381)
- Polymicrogyria (HP:0002126): Polymicrogyria is a congenital malformation of the cerebral cortex characterized by abnormal cortical layering (lamination) and an excessive number of small gyri (folds). Evidence: PCS. Frequency: 1/1. (PMID:24817631)